- Congenital onset (HP:0003577): A phenotypic abnormality that is present at birth. Evidence: PCS. (PMID:8001158)
- Aganglionic megacolon (HP:0002251): An abnormality resulting from a lack of intestinal ganglion cells (i.e., an aganglionic section of bowel) that results in bowel obstruction with enlargement of the colon. Evidence: PCS. (PMID:8001158)
- Autosomal dominant inheritance (HP:0000006): A mode of inheritance that is observed for traits related to a gene encoded on one of the autosomes (i.e., the human chromosomes 1-22) in which a trait manifests in heterozygotes. In the context of medical genetics, an autosomal dominant disorder is caused when a single copy of the mutant allele is present. Males and females are affected equally, and can both transmit the disorder with a risk of 50% for each child of inheriting the mutant allele. Evidence: PCS. (PMID:8001158)
These phenotypes are associated with the disease Hirschsprung disease, susceptibility to, 2 (OMIM:600155).